Phenotypes associated with the disease Tatsumi factor deficiency (OMIM:272650):
- Abnormal bleeding (HP:0001892): An abnormal susceptibility to bleeding, often referred to as a bleeding diathesis. A bleeding diathesis may be related to vascular, platelet and coagulation defects. Evidence: IEA. (OMIM:272650)
- Prolonged bleeding time (HP:0003010): Prolongation of the time taken for a standardized skin cut of fixed depth and length to stop bleeding. Evidence: IEA. (OMIM:272650)
- Autosomal recessive inheritance (HP:0000007): A mode of inheritance that is observed for traits related to a gene encoded on one of the autosomes (i.e., the human chromosomes 1-22) in which a trait manifests in individuals with two pathogenic alleles, either homozygotes (two copies of the same mutant allele) or compound heterozygotes (whereby each copy of a gene has a distinct mutant allele). Evidence: IEA. (OMIM:272650)
- Reduced prothrombin consumption (HP:0003337): The prothrombin consumption test measures the formation of intrinsic thromboplastin by determining the residual serum prothrombin after blood clotting is complete. If there is a defect in the process, less prothrombin will be converted to thrombin than normal (less prothrombin is consumed). This test may be abnormal with conditions including deficiency of factors VIII or IX, with circulating anticoagulants, thrombocytopenia. Evidence: IEA. (OMIM:272650)